Phenotypes associated with the disease Ledderhose disease (ORPHA:199251):
- Subcutaneous nodule (HP:0001482): Slightly elevated lesions on or in the skin with a diameter of over 5 mm. Evidence: TAS. Frequency: Frequent (HP:0040282). (ORPHA:199251)
- Arthralgia (HP:0002829): Joint pain. Evidence: TAS. Frequency: Very frequent (HP:0040281). (ORPHA:199251)
- Paresthesia (HP:0003401): Abnormal sensations such as tingling, pricking, or numbness of the skin with no apparent physical cause. Evidence: TAS. Frequency: Very frequent (HP:0040281). (ORPHA:199251)
- Peripheral neuropathy (HP:0009830): Peripheral neuropathy is a general term for any disorder of the peripheral nervous system. The main clinical features used to classify peripheral neuropathy are distribution, type (mainly demyelinating versus mainly axonal), duration, and course. Evidence: TAS. Frequency: Occasional (HP:0040283). (ORPHA:199251)
- Lack of skin elasticity (HP:0100679). Evidence: TAS. Frequency: Very frequent (HP:0040281). (ORPHA:199251)